Phenotypes associated with the disease Neurogenic thoracic outlet syndrome (ORPHA:100073):
- Sensory neuropathy (HP:0000763): Peripheral neuropathy affecting the sensory nerves. Evidence: TAS. Frequency: Occasional (HP:0040283). (ORPHA:100073)
- Abnormal rib morphology (HP:0000772): An anomaly of the rib. Evidence: TAS. Frequency: Frequent (HP:0040282). (ORPHA:100073)
- Muscle weakness (HP:0001324): Reduced strength of muscles. Evidence: TAS. Frequency: Occasional (HP:0040283). (ORPHA:100073)
- Arthralgia (HP:0002829): Joint pain. Evidence: TAS. Frequency: Very frequent (HP:0040281). (ORPHA:100073)
- Myalgia (HP:0003326): Pain in muscle. Evidence: TAS. Frequency: Very frequent (HP:0040281). (ORPHA:100073)
- Paresthesia (HP:0003401): Abnormal sensations such as tingling, pricking, or numbness of the skin with no apparent physical cause. Evidence: TAS. Frequency: Very frequent (HP:0040281). (ORPHA:100073)
- EMG abnormality (HP:0003457): Abnormal results of investigations using electromyography (EMG). Evidence: TAS. Frequency: Very frequent (HP:0040281). (ORPHA:100073)
- Dysesthesia (HP:0012534): Painful sensations elicited by a nonpainful cutaneous stimulus such as a light touch or gentle stroking over affected areas of the body. Sometimes referred to as hyperpathia or hyperalgesia. Often perceived as an intense burning, dyesthesias may outlast the stimulus by several seconds. Evidence: TAS. Frequency: Very frequent (HP:0040281). (ORPHA:100073)